Phenotypes associated with the disease mesomelic dysplasia, Kantaputra type (OMIM:156232):
- Mesomelia (HP:0003027): Shortening of the middle parts of the limbs (forearm and lower leg) in relation to the upper and terminal segments. Evidence: IEA. (OMIM:156232)
- Tarsal synostosis (HP:0008368): Synostosis (bony fusion) involving one or more bones of the tarsus (calcaneus, talus, cuboid, navicular, cuneiiform bones). Evidence: TAS. (OMIM:156232)
- Radial bowing (HP:0002986): A bending or abnormal curvature of the radius. Evidence: IEA. (OMIM:156232)
- Carpal synostosis (HP:0009702): Synostosis (bony fusion) involving one or more bones of the carpus (scaphoid, lunate, triquetrum, trapezium, trapezoid, capitate, hamate, pisiform). Evidence: TAS. (OMIM:156232)
- Autosomal dominant inheritance (HP:0000006): A mode of inheritance that is observed for traits related to a gene encoded on one of the autosomes (i.e., the human chromosomes 1-22) in which a trait manifests in heterozygotes. In the context of medical genetics, an autosomal dominant disorder is caused when a single copy of the mutant allele is present. Males and females are affected equally, and can both transmit the disorder with a risk of 50% for each child of inheriting the mutant allele. Evidence: IEA. (OMIM:156232)